Phenotypes associated with the disease Secondary hypoparathyroidism due to impaired parathormon secretion (ORPHA:140286):
- Abnormality of the parathyroid gland (HP:0000828): An abnormality of the parathyroid gland. Evidence: TAS. Frequency: Very frequent (HP:0040281). (ORPHA:140286)
- Nephrocalcinosis (HP:0000121): Nephrocalcinosis is the deposition of calcium salts in renal parenchyma. Evidence: TAS. Frequency: Frequent (HP:0040282). (ORPHA:140286)
- Hypoparathyroidism (HP:0000829): A condition caused by a deficiency of parathyroid hormone characterized by hypocalcemia and hyperphosphatemia. Evidence: TAS. Frequency: Frequent (HP:0040282). (ORPHA:140286)
- Basal ganglia calcification (HP:0002135): The presence of calcium deposition affecting one or more structures of the basal ganglia. Evidence: TAS. Frequency: Frequent (HP:0040282). (ORPHA:140286)
- Hypocalcemia (HP:0002901): The concentration of calcium in the blood circulation is below the lower limit of normal. Evidence: TAS. Frequency: Frequent (HP:0040282). (ORPHA:140286)
- Hyperphosphatemia (HP:0002905): The concentration of phosphate ion in the blood circulation is above the upper limit of normal. Evidence: TAS. Frequency: Frequent (HP:0040282). (ORPHA:140286)
- Fatigue (HP:0012378): A subjective feeling of tiredness characterized by a lack of energy and motivation. Evidence: TAS. Frequency: Frequent (HP:0040282). (ORPHA:140286)
- Decreased circulating parathyroid hormone level (HP:0031817): An abnormally decreased concentration of parathyroid hormone. Evidence: TAS. Frequency: Frequent (HP:0040282). (ORPHA:140286)
- Depression (HP:0000716): Frequently experiencing feelings of being down, miserable, and/or hopeless; struggling to recover from these moods; having a pessimistic outlook on the future; feeling a pervasive sense of shame; having a low self-worth; experiencing thoughts of suicide and engaging in suicidal behavior. Evidence: TAS. Frequency: Occasional (HP:0040283). (ORPHA:140286)
- Anxiety (HP:0000739): Intense feelings of nervousness, tension, or panic often arise in response to interpersonal stresses. There is worry about the negative effects of past unpleasant experiences and future negative possibilities. Individuals may feel fearful, apprehensive, or threatened by uncertainty, and they may also have fears of falling apart or losing control. Evidence: TAS. Frequency: Occasional (HP:0040283). (ORPHA:140286)
- Seizure (HP:0001250): A seizure is an intermittent abnormality of nervous system physiology characterized by a transient occurrence of signs and/or symptoms due to abnormal excessive or synchronous neuronal activity in the brain. Evidence: TAS. Frequency: Occasional (HP:0040283). (ORPHA:140286)
- Hypercalciuria (HP:0002150). Evidence: TAS. Frequency: Occasional (HP:0040283). (ORPHA:140286)
- Fasciculations (HP:0002380): Fasciculations are observed as small, local, involuntary muscle contractions (twitching) visible under the skin. Fasciculations result from increased irritability of an axon (which in turn is often a manifestation of disease of a motor neuron). This leads to sporadic discharges of all the muscle fibers controlled by the axon in isolation from other motor units. Evidence: TAS. Frequency: Occasional (HP:0040283). (ORPHA:140286)
- Rickets (HP:0002748): Rickets is divided into two major categories including calcipenic and phosphopenic. Hypophosphatemia is described as a common manifestation of both categories. Hypophosphatemic rickets is the most common type of rickets that is characterized by low levels of serum phosphate, resistance to ultraviolet radiation or vitamin D intake. There are several issues involved in hypophosphatemic rickets such as calcium, vitamin D, phosphorus deficiencies. Moreover, other disorder can be associated with its occurrence such as absorption defects due to pancreatic, intestinal, gastric, and renal disorders and hepatobiliary disease. Symptoms are usually seen in childhood and can be varied in severity. Severe forms may be linked to bowing of the legs, poor bone growth, and short stature as well as joint and bone pain. Hypophosphatemic rickets are associated with renal excretion of phosphate, hypophosphatemia, and mineral defects in bones. The familial type of the disease is the most common type of rickets. Evidence: TAS. Frequency: Occasional (HP:0040283). (ORPHA:140286)
- Osteomalacia (HP:0002749): Osteomalacia is a general term for bone weakness owing to a defect in mineralization of the protein framework known as osteoid. This defective mineralization is mainly caused by lack in vitamin D. Osteomalacia in children is known as rickets. Evidence: TAS. Frequency: Occasional (HP:0040283). (ORPHA:140286)
- Muscle spasm (HP:0003394): Sudden and involuntary contractions of one or more muscles. Evidence: TAS. Frequency: Occasional (HP:0040283). (ORPHA:140286)
- Bipolar affective disorder (HP:0007302): Bipolar disorder is an illness of mood characterized by alternating episodes of elevated and depressed moods, which are interspersed with euthymic periods. Evidence: TAS. Frequency: Occasional (HP:0040283). (ORPHA:140286)
- Posterior subcapsular cataract (HP:0007787): A type of cataract affecting the posterior pole of lens immediately adjacent to ('beneath') the Lens capsule. Evidence: TAS. Frequency: Occasional (HP:0040283). (ORPHA:140286)
- Arrhythmia (HP:0011675): Any cardiac rhythm other than the normal sinus rhythm. Such a rhythm may be either of sinus or ectopic origin and either regular or irregular. An arrhythmia may be due to a disturbance in impulse formation or conduction or both. Evidence: TAS. Frequency: Occasional (HP:0040283). (ORPHA:140286)
- Laryngospasm (HP:0025425): A spasm (involuntary contraction) of the vocal cords that can make it difficult to speak or breathe. Evidence: TAS. Frequency: Occasional (HP:0040283). (ORPHA:140286)
- Acroparesthesia (HP:0031006): A type of paresthesia (tingling, pins-and-needles, burning or numbness or stiffness) that occurs in the hands and feet and particularly in the fingers and toes. Evidence: TAS. Frequency: Occasional (HP:0040283). (ORPHA:140286)
- Chvostek sign (HP:0031990): A contraction of ipsilateral facial muscles subsequent to percussion over the facial nerve. Evidence: TAS. Frequency: Occasional (HP:0040283). (ORPHA:140286)
- Brain fog (HP:0033630): Brain fog is a type of transient cognitive dysfunction that comprises a constellation of symptoms that impair intellectual functioning to a level that interferes with daily activities, commonly including forgetfulness, mental slowness, difficulty thinking or focusing, a perceived slowing of mental processing speed, inability to find the right words, a sensation that the mind went blank or is "cloudy". Brain fog tends to recur and may be triggered by factors such as physical fatigue, lack of sleep, and prolonged standing or may appear to occur spontaneously. Evidence: TAS. Frequency: Occasional (HP:0040283). (ORPHA:140286)
- Hypoesthesia (HP:0033748): Decreased ability to perceive touch. Evidence: TAS. Frequency: Occasional (HP:0040283). (ORPHA:140286)
- Bronchoconstriction (HP:4000007): Tightening of smooth muscle surrounding the bronchi and bronchioles with consequent wheezing and shortness of breath. Evidence: TAS. Frequency: Occasional (HP:0040283). (ORPHA:140286)
- Trousseau sign (HP:6000919): After inflating a blood pressure cuff from 10 mm Hg to 20 mm Hg over the patient's systolic blood pressure, the Trousseau sign is considered positive if carpal spasm develops, with flexion of the thumb and adduction of the finger within 3 minutes. However, this can be painful, so the time should be noted, and the cuff should be deflated once the test is positive. Evidence: TAS. Frequency: Occasional (HP:0040283). (ORPHA:140286)